Phenotypes associated with the disease Brugada syndrome 8 (OMIM:613123):
- ST segment elevation (HP:0012251): An electrocardiographic anomaly in which the ST segment is observed to be located superior to the isoelectric line. Evidence: PCS. Frequency: 1/1. (PMID:19165230)
- Complete right bundle branch block (HP:0011712): A conduction block of the right branch of the bundle of His. This manifests as a prolongation of the QRS complex (greater than 0.12 s) with delayed activation of the right ventricle and terminal delay on the EKG. Evidence: PCS. Frequency: 1/1. (PMID:19165230)
- Ventricular tachycardia (HP:0004756): A tachycardia originating in the ventricles characterized by rapid heart rate (over 100 beats per minute) and broad QRS complexes (over 120 ms). Evidence: PCS. Frequency: 1/1. (PMID:19165230)